- Hypomimic face (HP:0000338): A reduced degree of motion of the muscles beneath the skin of the face, often associated with reduced facial crease formation. Evidence: TAS. Frequency: Frequent (HP:0040282). (ORPHA:70594)
- Abnormality of the nose (HP:0000366): An abnormality of the nose. Evidence: TAS. Frequency: Frequent (HP:0040282). (ORPHA:70594)
- Ptosis (HP:0000508): The upper eyelid margin is positioned 3 mm or more lower than usual and covers the superior portion of the iris (objective); or, the upper lid margin obscures at least part of the pupil (subjective). Evidence: TAS. Frequency: Frequent (HP:0040282). (ORPHA:70594)
- Atypical behavior (HP:0000708): Atypical behavior is an abnormality in a person's actions that can be controlled or modulated by the will of the individual. While abnormal behaviors can be difficult to control, they are distinct from other abnormal actions that cannot be affected by the individual's will. Evidence: TAS. Frequency: Frequent (HP:0040282). (ORPHA:70594)
- Delayed speech and language development (HP:0000750): A degree of language development that is significantly below the norm for a child of a specified age. Evidence: TAS. Frequency: Frequent (HP:0040282). (ORPHA:70594)
- Hyperhidrosis (HP:0000975): Abnormal excessive perspiration (sweating) despite the lack of appropriate stimuli like hot and humid weather. Evidence: TAS. Frequency: Frequent (HP:0040282). (ORPHA:70594)
- Intellectual disability (HP:0001249): The term intellectual disability or intellectual developmental disorder is used to describe significantly sub-average intellectual and adaptive functioning based on clinical assessment and as measured by individually administered, appropriately normed, standardized and validated tests of intellectual functioning and adaptive behavior, with onset during the developmental period from infancy through adolescence. Evidence: TAS. Frequency: Frequent (HP:0040282). (ORPHA:70594)
- Motor delay (HP:0001270): A type of Developmental delay characterized by a delay in acquiring motor skills. Evidence: TAS. Frequency: Frequent (HP:0040282). (ORPHA:70594)
- Muscle weakness (HP:0001324): Reduced strength of muscles. Evidence: TAS. Frequency: Frequent (HP:0040282). (ORPHA:70594)
- Dystonia (HP:0001332): An abnormally increased muscular tone that causes fixed abnormal postures. There is a slow, intermittent twisting motion that leads to exaggerated turning and posture of the extremities and trunk. Evidence: TAS. Frequency: Frequent (HP:0040282). (ORPHA:70594)
- Tremor (HP:0001337): An unintentional, oscillating to-and-fro muscle movement about a joint axis. Evidence: TAS. Frequency: Frequent (HP:0040282). (ORPHA:70594)
- Hyperreflexia (HP:0001347): Hyperreflexia is the presence of hyperactive stretch reflexes of the muscles. Evidence: TAS. Frequency: Frequent (HP:0040282). (ORPHA:70594)
- Rigidity (HP:0002063): Continuous involuntary sustained muscle contraction. When an affected muscle is passively stretched, the degree of resistance remains constant regardless of the rate at which the muscle is stretched. This feature helps to distinguish rigidity from muscle spasticity. Evidence: TAS. Frequency: Frequent (HP:0040282). (ORPHA:70594)
- Bradykinesia (HP:0002067): Bradykinesia literally means slow movement, and is used clinically to denote a slowness in the execution of movement (in contrast to hypokinesia, which is used to refer to slowness in the initiation of movement). Evidence: TAS. Frequency: Frequent (HP:0040282). (ORPHA:70594)
- Drowsiness (HP:0002329): Abnormal feeling of sleepiness or difficulty staying awake. Evidence: TAS. Frequency: Frequent (HP:0040282). (ORPHA:70594)
- Sleep disturbance (HP:0002360): An abnormal pattern in the quality, quantity, or characteristics of sleep. Evidence: TAS. Frequency: Frequent (HP:0040282). (ORPHA:70594)
- Limb hypertonia (HP:0002509). Evidence: TAS. Frequency: Frequent (HP:0040282). (ORPHA:70594)
- Temperature instability (HP:0005968): Disordered thermoregulation characterized by an impaired ability to maintain a balance between heat production and heat loss, with resulting instability of body temperature. Evidence: TAS. Frequency: Frequent (HP:0040282). (ORPHA:70594)
- Axial hypotonia (HP:0008936): Muscular hypotonia (abnormally low muscle tone) affecting the musculature of the trunk. Evidence: TAS. Frequency: Frequent (HP:0040282). (ORPHA:70594)
- Oculogyric crisis (HP:0010553): An acute dystonic reaction with blepharospasm, periorbital twitches, and protracted fixed staring episodes. There may be a maximal upward deviation of the eyes in the sustained fashion. Oculogyric crisis can be triggered by a number of factors including neuroleptic medications. Evidence: TAS. Frequency: Frequent (HP:0040282). (ORPHA:70594)
- Cognitive impairment (HP:0100543): Abnormal cognition is characterized by deficits in thinking, reasoning, or remembering. Evidence: TAS. Frequency: Frequent (HP:0040282). (ORPHA:70594)
- Microcephaly (HP:0000252): Head circumference below 2 standard deviations below the mean for age and gender. Evidence: TAS. Frequency: Occasional (HP:0040283). (ORPHA:70594)
- Seizure (HP:0001250): A seizure is an intermittent abnormality of nervous system physiology characterized by a transient occurrence of signs and/or symptoms due to abnormal excessive or synchronous neuronal activity in the brain. Evidence: TAS. Frequency: Occasional (HP:0040283). (ORPHA:70594)
- Growth delay (HP:0001510): A deficiency or slowing down of growth pre- and postnatally. Evidence: TAS. Frequency: Occasional (HP:0040283). (ORPHA:70594)
- Small for gestational age (HP:0001518): Smaller than normal size according to sex and gestational age related norms, defined as a weight below the 10th percentile for the gestational age. Evidence: TAS. Frequency: Occasional (HP:0040283). (ORPHA:70594)
- Cerebral palsy (HP:0100021): Cerebral palsy describes a group of permanent disorders of the development of movement and posture, causing activity limitation, that are attributed to nonprogressive disturbances that occurred in the developing fetal or infant brain. The motor disorders of cerebral palsy are often accompanied by disturbances of sensation, perception, cognition, communication, and behavior, by epilepsy, and by secondary musculoskeletal problems. Evidence: TAS. Frequency: Occasional (HP:0040283). (ORPHA:70594)
These phenotypes are associated with the disease Dopa-responsive dystonia due to sepiapterin reductase deficiency (ORPHA:70594).